- Astigmatism (HP:0000483): A type of refraction error associated with abnormal curvatures on the anterior and/or posterior surface of the cornea. Evidence: TAS. Frequency: Very frequent (HP:0040281). (ORPHA:178333)
- Abnormal electroretinogram (HP:0000512): Any abnormality of the electrical responses of various cell types in the retina as measured by electroretinography. Evidence: TAS. Frequency: Very frequent (HP:0040281). (ORPHA:178333)
- Myopia (HP:0000545): An abnormality of refraction characterized by the ability to see objects nearby clearly, while objects in the distance appear blurry. Evidence: TAS. Frequency: Very frequent (HP:0040281). (ORPHA:178333)
- Color vision defect (HP:0000551): An anomaly in the ability to discriminate between or recognize colors. Evidence: TAS. Frequency: Very frequent (HP:0040281). (ORPHA:178333)
- Nystagmus (HP:0000639): Rhythmic, involuntary oscillations of one or both eyes related to abnormality in fixation, conjugate gaze, or vestibular mechanisms. Evidence: TAS. Frequency: Very frequent (HP:0040281). (ORPHA:178333)
- Reduced visual acuity (HP:0007663). Evidence: TAS. Frequency: Very frequent (HP:0040281). (ORPHA:178333)
- Hypoplasia of the fovea (HP:0007750): Underdevelopment of the fovea centralis. Evidence: TAS. Frequency: Very frequent (HP:0040281). (ORPHA:178333)
- Fundus hypopigmentation (HP:0007894): Generalized or focal reduced pigmentation of the fundus, evaluated in the context of skin and hair color. Fundoscopy may reveal a low level pigment. Evidence: TAS. Frequency: Very frequent (HP:0040281). (ORPHA:178333)
- Difficulty adjusting from light to dark (HP:0030513). Evidence: TAS. Frequency: Very frequent (HP:0040281). (ORPHA:178333)
These phenotypes are associated with the disease Åland Islands eye disease (ORPHA:178333).